Phenotypes associated with the disease Bullous lichen planus (ORPHA:33408):
- Pruritus (HP:0000989): Pruritus is an itch or a sensation that makes a person want to scratch. This term refers to an abnormally increased disposition to experience pruritus. Evidence: TAS. Frequency: Occasional (HP:0040283). (ORPHA:33408)
- Abnormal blistering of the skin (HP:0008066): The presence of one or more bullae on the skin, defined as fluid-filled blisters more than 5 mm in diameter with thin walls. Evidence: TAS. Frequency: Very frequent (HP:0040281). (ORPHA:33408)
- Lichenification (HP:0100725): Thickening and hardening of the epidermis seen with exaggeration of normal skin lines. Evidence: TAS. Frequency: Very frequent (HP:0040281). (ORPHA:33408)
- Breast aplasia (HP:0100783): Failure to develop and congenital absence of the breast. Evidence: TAS. Frequency: Very frequent (HP:0040281). (ORPHA:33408)
- Papule (HP:0200034): A circumscribed, solid elevation of skin with no visible fluid, varying in size from a pinhead to less than 10mm in diameter at the widest point. Evidence: TAS. Frequency: Very frequent (HP:0040281). (ORPHA:33408)